- Young adult onset (HP:0011462): Onset of disease at the age of between 16 and 40 years. Evidence: PCS. Frequency: 1/1. (PMID:28199965)
- Male infertility (HP:0003251). Evidence: PCS. Frequency: 1/1. (PMID:28199965)
- Reduced sperm motility (HP:0012207): An abnormal reduction in the mobility of ejaculated sperm. Evidence: PCS. Frequency: 1/1. (PMID:28199965)
- Autosomal recessive inheritance (HP:0000007): A mode of inheritance that is observed for traits related to a gene encoded on one of the autosomes (i.e., the human chromosomes 1-22) in which a trait manifests in individuals with two pathogenic alleles, either homozygotes (two copies of the same mutant allele) or compound heterozygotes (whereby each copy of a gene has a distinct mutant allele). Evidence: PCS. (PMID:28199965)
- Acephalic spermatozoa (HP:0012869): Spermatozoa with very small cranial ends devoid of any nuclear material, that is, lacking a typical sperm head. Evidence: PCS. Frequency: 1/1. (PMID:28199965)
These phenotypes are associated with the disease spermatogenic failure 21 (OMIM:617644).